- Secundum atrial septal defect (HP:0001684): A kind of atrial septum defect arising from an enlarged foramen ovale, inadequate growth of the septum secundum, or excessive absorption of the septum primum. Evidence: PCS. Frequency: 1/3. (PMID:37561591)
- Infantile onset (HP:0003593): Onset of signs or symptoms of disease between 28 days to one year of life. Evidence: PCS. Frequency: 3/3. (PMID:32870709;PMID:37561591)
- Autosomal recessive inheritance (HP:0000007): A mode of inheritance that is observed for traits related to a gene encoded on one of the autosomes (i.e., the human chromosomes 1-22) in which a trait manifests in individuals with two pathogenic alleles, either homozygotes (two copies of the same mutant allele) or compound heterozygotes (whereby each copy of a gene has a distinct mutant allele). Evidence: PCS. (PMID:32870709)
- Congestive heart failure (HP:0001635): The presence of an abnormality of cardiac function that is responsible for the failure of the heart to pump blood at a rate that is commensurate with the needs of the tissues or a state in which abnormally elevated filling pressures are required for the heart to do so. Heart failure is frequently related to a defect in myocardial contraction. Evidence: PCS. Frequency: 2/3. (PMID:37561591)
- Severely reduced left ventricular ejection fraction (HP:0012666): A large reduction in the fraction of blood pumped from the left ventricle with each cardiac cycle. The normal range in adults is at over 50 percent, and a severe reduction is defined as less than 30 percent. Evidence: PCS. Frequency: 3/3. (PMID:37561591)
- Dilated cardiomyopathy (HP:0001644): Dilated cardiomyopathy (DCM) is defined by the presence of left ventricular dilatation and left ventricular systolic dysfunction in the absence of abnormal loading conditions (hypertension, valve disease) or coronary artery disease sufficient to cause global systolic impairment. Right ventricular dilation and dysfunction may be present but are not necessary for the diagnosis. Evidence: PCS. Frequency: 3/3. (PMID:37561591)
These phenotypes are associated with the disease cardiomyopathy, dilated, 2j (OMIM:620635).